Phenotypes associated with the disease Posterior fusion of lumbosacral vertebrae-blepharoptosis syndrome (ORPHA:2064):
- Ptosis (HP:0000508): The upper eyelid margin is positioned 3 mm or more lower than usual and covers the superior portion of the iris (objective); or, the upper lid margin obscures at least part of the pupil (subjective). Evidence: TAS. Frequency: Very frequent (HP:0040281). (ORPHA:2064)
- Sacral dimple (HP:0000960): A cutaneous indentation resulting from tethering of the skin to underlying structures (bone) of the intergluteal cleft. Evidence: TAS. Frequency: Frequent (HP:0040282). (ORPHA:2064)
- Joint stiffness (HP:0001387): Joint stiffness is a perceived sensation of tightness in a joint or joints when attempting to move them after a period of inactivity. Joint stiffness typically subsides over time. Evidence: TAS. Frequency: Frequent (HP:0040282). (ORPHA:2064)
- Abnormal vertebral body morphology (HP:0003312): Abnormal form of vertebral body, which is the central cylindrical portion of the vertebra that together with other structures such as the vertebral arch, pedicles, laminae, spinous process, transverse processes, and articular facets makes up a vertebra. Evidence: TAS. Frequency: Very frequent (HP:0040281). (ORPHA:2064)
- Posterior fusion of lumbosacral vertebrae (HP:0005626): Bony fusion of the posterior part of the L5 vertebral body with the sacrum. Evidence: TAS. Frequency: Very frequent (HP:0040281). (ORPHA:2064)
- Tarsal synostosis (HP:0008368): Synostosis (bony fusion) involving one or more bones of the tarsus (calcaneus, talus, cuboid, navicular, cuneiiform bones). Evidence: TAS. Frequency: Frequent (HP:0040282). (ORPHA:2064)